Phenotypes associated with the disease Rheumatic fever-related antigenrheumatic fever, acute, susceptibility to, included (OMIM:268240):
- Abnormality of the immune system (HP:0002715): An abnormality of the immune system. Evidence: IEA. (OMIM:268240)
- Autosomal recessive inheritance (HP:0000007): A mode of inheritance that is observed for traits related to a gene encoded on one of the autosomes (i.e., the human chromosomes 1-22) in which a trait manifests in individuals with two pathogenic alleles, either homozygotes (two copies of the same mutant allele) or compound heterozygotes (whereby each copy of a gene has a distinct mutant allele). Evidence: TAS. (OMIM:268240)
- Fever (HP:0001945): Body temperature elevated above the normal range. Evidence: IEA. (OMIM:268240)